- Progressive (HP:0003676): Applies to a disease manifestation that increases in scope or severity over the course of time, i.e., that worsens with age. Evidence: TAS. (OMIM:126900)
- Joint contracture of the hand (HP:0009473): Contractures of one ore more joints of the hands meaning chronic loss of joint motion due to structural changes in non-bony tissue. Evidence: IEA. (OMIM:126900)
- Adult onset (HP:0003581): Onset of disease manifestations in adulthood, defined here as at the age of 16 years or later. Evidence: TAS. (OMIM:126900)
- Typified by incomplete penetrance (HP:0003829): Description of conditions in which not all individuals with a given genotype exhibit the disease. Penetrance is the proportion that develop disease given a lifespan of 80 years. Evidence: TAS. (OMIM:126900)
- Autosomal dominant inheritance (HP:0000006): A mode of inheritance that is observed for traits related to a gene encoded on one of the autosomes (i.e., the human chromosomes 1-22) in which a trait manifests in heterozygotes. In the context of medical genetics, an autosomal dominant disorder is caused when a single copy of the mutant allele is present. Males and females are affected equally, and can both transmit the disorder with a risk of 50% for each child of inheriting the mutant allele. Evidence: TAS. (OMIM:126900)
- Dupuytren contracture (HP:0005679): An abnormality of the hand resulting from contracture of the palmar fascia with a fixed flexion deformity of the metacarpophalangeal (MCP) joints and the proximal interphalangeal (PIP) joints. Evidence: PCS. (PMID:16207209)
These phenotypes are associated with the disease familial Dupuytren contracture (OMIM:126900).